Phenotypes associated with the disease Intermittent hydrarthrosis (ORPHA:329967):
- Joint swelling (HP:0001386). Evidence: TAS. Frequency: Very frequent (HP:0040281). (ORPHA:329967)
- Arthralgia (HP:0002829): Joint pain. Evidence: TAS. Frequency: Occasional (HP:0040283). (ORPHA:329967)
- Abnormality of the knee (HP:0002815): An abnormality of the knee joint or surrounding structures. Evidence: TAS. Frequency: Frequent (HP:0040282). (ORPHA:329967)
- Knee joint hypermobility (HP:0045086): The ability of the knee to move past its normal range of motion, (knee hyperextension is greater than 10 degrees). Evidence: TAS. Frequency: Occasional (HP:0040283). (ORPHA:329967)
- Chondrocalcinosis (HP:0000934): Radiographic evidence of articular calcification that represent calcium pyrophosphate depositions in soft tissue surrounding joints and at the insertions of tendons near joints (Entheses/Sharpey fibers) . Evidence: TAS. Frequency: Very rare (HP:0040284). (ORPHA:329967)